Phenotypes associated with the disease abducens nerve palsy (OMIM:100200):
- Strabismus (HP:0000486): A misalignment of the eyes so that the visual axes deviate from bifoveal fixation. The classification of strabismus may be based on a number of features including the relative position of the eyes, whether the deviation is latent or manifest, intermittent or constant, concomitant or otherwise and according to the age of onset and the relevance of any associated refractive error. Evidence: IEA. (OMIM:100200)
- Abducens palsy (HP:0006897): Malfunction of the abducens nerve as manifested by impairment of the ability of the affected eye to be moved outward. Patients who develop abducens nerve palsy often present with binocular horizontal diplopia, which is a double vision when looking at objects side by side. There will be a notable weakness of the ipsilateral lateral rectus muscle leading to a deficit in of eye abduction on the affected side. Some patients may present with a constant head turning movement to maintain binocular fusion and to lessen the degree of diplopia. Evidence: IEA. (OMIM:100200)
- Autosomal dominant inheritance (HP:0000006): A mode of inheritance that is observed for traits related to a gene encoded on one of the autosomes (i.e., the human chromosomes 1-22) in which a trait manifests in heterozygotes. In the context of medical genetics, an autosomal dominant disorder is caused when a single copy of the mutant allele is present. Males and females are affected equally, and can both transmit the disorder with a risk of 50% for each child of inheriting the mutant allele. Evidence: IEA. (OMIM:100200)